- Abnormal circulating interleukin concentration (HP:0011117): The concentration of an interleukin (a class of cytokines) is outside the limits of normal. Evidence: TAS. Frequency: Very frequent (HP:0040281). (ORPHA:70578)
- Dyspnea (HP:0002094): Difficult or labored breathing. Dyspnea is a subjective feeling only the patient can rate, e.g., on a Borg scale. Evidence: TAS. Frequency: Very frequent (HP:0040281). (ORPHA:70578)
- Pulmonary infiltrates (HP:0002113). Evidence: TAS. Frequency: Very frequent (HP:0040281). (ORPHA:70578)
- Abnormal blood gas level (HP:0012415): An abnormality of the partial pressure of oxygen or carbon dioxide in the arterial blood. Evidence: TAS. Frequency: Very frequent (HP:0040281). (ORPHA:70578)
- Hypoxemia (HP:0012418): An abnormally low level of blood oxygen. Evidence: TAS. Frequency: Very frequent (HP:0040281). (ORPHA:70578)
- Metabolic acidosis (HP:0001942): Metabolic acidosis (MA) is characterized by a fall in blood pH due to a reduction of serum bicarbonate concentration. This can occur as a result of either the accumulation of acids (high anion gap MA) or the loss of bicarbonate from the gastrointestinal tract or the kidney (hyperchloremic MA). By definition, MA is not due to a respirary cause. Evidence: TAS. Frequency: Frequent (HP:0040282). (ORPHA:70578)
- Hypotension (HP:0002615): Low Blood Pressure, vascular hypotension. Evidence: TAS. Frequency: Frequent (HP:0040282). (ORPHA:70578)
- Respiratory failure (HP:0002878): A severe form of respiratory insufficiency characterized by inadequate gas exchange such that the levels of oxygen or carbon dioxide cannot be maintained within normal limits. Evidence: TAS. Frequency: Frequent (HP:0040282). (ORPHA:70578)
- Abnormality of tumor necrosis factor secretion (HP:0011118): An abnormality in the production or cellular release of tumor necrosis factor. Evidence: TAS. Frequency: Frequent (HP:0040282). (ORPHA:70578)
- Increased circulating interleukin 6 concentration (HP:0030783): The concentration of interleukin-6 in the blood circulation is above the upper limit of normal. Evidence: TAS. Frequency: Frequent (HP:0040282). (ORPHA:70578)
- Shock (HP:0031273): The state in which profound and widespread reduction of effective tissue perfusion leads first to reversible, and then if prolonged, to irreversible cellular injury. Evidence: TAS. Frequency: Frequent (HP:0040282). (ORPHA:70578)
- Pulmonary edema (HP:0100598): Fluid accumulation in the lungs. Evidence: TAS. Frequency: Frequent (HP:0040282). (ORPHA:70578)
- Sepsis (HP:0100806): Sepsis is defined as life-threatening organ dysfunction caused by a dysregulated host response to infection. Evidence: TAS. Frequency: Frequent (HP:0040282). (ORPHA:70578)
- Pneumonia (HP:0002090): Inflammation of any part of the lung parenchyma. Evidence: TAS. Frequency: Occasional (HP:0040283). (ORPHA:70578)
- Pancreatitis (HP:0001733): The presence of inflammation in the pancreas. Evidence: TAS. Frequency: Very rare (HP:0040284). (ORPHA:70578)
- Diabetic ketoacidosis (HP:0001953): A type of diabetic metabolic abnormality with an accumulation of ketone bodies. Evidence: TAS. Frequency: Very rare (HP:0040284). (ORPHA:70578)
- Vasculitis (HP:0002633): Inflammation of blood vessel. Evidence: TAS. Frequency: Very rare (HP:0040284). (ORPHA:70578)
These phenotypes are associated with the disease Adult acute respiratory distress syndrome (ORPHA:70578).